Phenotypes associated with the disease autism, susceptibility to, X-linked 1 (OMIM:300425):
- Delayed speech and language development (HP:0000750): A degree of language development that is significantly below the norm for a child of a specified age. Evidence: IEA. Frequency: Frequent (HP:0040282). (OMIM:300425)
- EEG abnormality (HP:0002353): Abnormality observed by electroencephalogram (EEG), which is used to record of the brain's spontaneous electrical activity from multiple electrodes placed on the scalp. Evidence: TAS. (OMIM:300425)
- Lack of peer relationships (HP:0002332): The state of not having relationships with peers outside of school or organized activity appropriate to developmental level. This may be caused by behavioral or physical barriers. Evidence: IEA. (OMIM:300425)
- Seizure (HP:0001250): A seizure is an intermittent abnormality of nervous system physiology characterized by a transient occurrence of signs and/or symptoms due to abnormal excessive or synchronous neuronal activity in the brain. Evidence: IEA. Frequency: Frequent (HP:0040282). (OMIM:300425)
- Increased serum serotonin (HP:0003144): A increased concentration of serotonin in the blood. Evidence: IEA. Frequency: Frequent (HP:0040282). (OMIM:300425)
- Childhood onset (HP:0011463): Onset of disease at the age of between 1 and 5 years. Evidence: PCS. Frequency: 1/1. (PMID:12669065)
- Autism (HP:0000717): Autism is a neurodevelopmental disorder characterized by impaired social interaction and communication, and by restricted and repetitive behavior. Autism begins in childhood. It is marked by the presence of markedly abnormal or impaired development in social interaction and communication and a markedly restricted repertoire of activity and interest. Manifestations of the disorder vary greatly depending on the developmental level and chronological age of the individual (DSM-IV). Evidence: PCS. Frequency: 1/2. (PMID:12669065)
- Restrictive behavior (HP:0000723): Behavior characterized by an abnormal limitation to a few interests and activities. Evidence: TAS. (OMIM:300425)
- Motor stereotypy (HP:0000733): Use of the same abnormal action in response to certain triggers or at random. They may be used as a way to regulate one's internal state but must otherwise have no apparent functional purpose. Evidence: TAS. (OMIM:300425)
- Abnormal nonverbal communicative behavior (HP:0000758): Abnormalities in eye contact, communicative facial expressions, gesture use, or the use of others' bodies to communicate convey shared meanings within a culture that replace or supplement verbal communication. Evidence: IEA. (OMIM:300425)
- X-linked inheritance (HP:0001417): A mode of inheritance that is observed for traits related to a gene encoded on the X chromosome. Evidence: PCS. (PMID:12669065)
- Inflexible adherence to routines (HP:0000732): A need to strictly adhere to repetitive routines or patterns of behavior which are created by the environment. One becomes upset or distressed when their routines are disrupted or altered. Evidence: IEA. (OMIM:300425)
- Intellectual disability (HP:0001249): The term intellectual disability or intellectual developmental disorder is used to describe significantly sub-average intellectual and adaptive functioning based on clinical assessment and as measured by individually administered, appropriately normed, standardized and validated tests of intellectual functioning and adaptive behavior, with onset during the developmental period from infancy through adolescence. Evidence: IEA. (OMIM:300425)
- Lack of spontaneous play (HP:0000721). Evidence: IEA. (OMIM:300425)